- Pallor (HP:0000980, a Human Phenotype Ontology term): Abnormally pale skin. Evidence: TAS. Frequency: Very frequent (HP:0040281, a Human Phenotype Ontology term). (ORPHA:90064)
- Limb pain (HP:0009763, a Human Phenotype Ontology term): Chronic pain in the limbs with no clear focal etiology. Evidence: TAS. Frequency: Very frequent (HP:0040281, a Human Phenotype Ontology term). (ORPHA:90064)
- Abnormal skin morphology (HP:0011121, a Human Phenotype Ontology term): Any morphological abnormality of the skin. Evidence: TAS. Frequency: Very frequent (HP:0040281, a Human Phenotype Ontology term). (ORPHA:90064)
- Lower limb pain (HP:0012514, a Human Phenotype Ontology term): An unpleasant sensation characterized by physical discomfort (such as pricking, throbbing, or aching) localized to the leg. Evidence: TAS. Frequency: Very frequent (HP:0040281, a Human Phenotype Ontology term). (ORPHA:90064)
- Abnormal capillary physiology (HP:0025018, a Human Phenotype Ontology term): A functional anomaly of the tiny blood vessels that connect arterioles with venules and whose walls act as semipermeable membranes that mediate the diffusion of fluids and gases between the blood circulation and body tissues. Evidence: TAS. Frequency: Very frequent (HP:0040281, a Human Phenotype Ontology term). (ORPHA:90064)
- Increased total leukocyte count (HP:0001974, a Human Phenotype Ontology term): An abnormal increase in the number of leukocytes in the blood. Evidence: TAS. Frequency: Frequent (HP:0040282, a Human Phenotype Ontology term). (ORPHA:90064)
- Paresthesia (HP:0003401, a Human Phenotype Ontology term): Abnormal sensations such as tingling, pricking, or numbness of the skin with no apparent physical cause. Evidence: TAS. Frequency: Frequent (HP:0040282, a Human Phenotype Ontology term). (ORPHA:90064)
- Limb muscle weakness (HP:0003690, a Human Phenotype Ontology term): Reduced strength and weakness of the muscles of the arms and legs. Evidence: TAS. Frequency: Frequent (HP:0040282, a Human Phenotype Ontology term). (ORPHA:90064)
- Impaired distal tactile sensation (HP:0006937, a Human Phenotype Ontology term): A reduced sense of touch (tactile sensation) on the skin of the distal limbs. This is usually tested with a wisp of cotton or a fine camel's hair brush, by asking patients to say 'now' each time they feel the stimulus. Evidence: TAS. Frequency: Frequent (HP:0040282, a Human Phenotype Ontology term). (ORPHA:90064)
- Abnormality of venous physiology (HP:0030846, a Human Phenotype Ontology term): An anomaly of venous function. Evidence: TAS. Frequency: Frequent (HP:0040282, a Human Phenotype Ontology term). (ORPHA:90064)
- Absent ankle pulse (HP:0031271, a Human Phenotype Ontology term): The pulsation of the posterior tibial artery behind the internal malleolus, or of the dorsalis pedis artery, cannot be detected on physical examination. Evidence: TAS. Frequency: Frequent (HP:0040282, a Human Phenotype Ontology term). (ORPHA:90064)
- Stroke (HP:0001297, a Human Phenotype Ontology term): Sudden impairment of blood flow to a part of the brain due to occlusion or rupture of an artery to the brain. Evidence: TAS. Frequency: Occasional (HP:0040283, a Human Phenotype Ontology term). (ORPHA:90064)
- Myocardial infarction (HP:0001658, a Human Phenotype Ontology term): Necrosis of the myocardium caused by an obstruction of the blood supply to the heart and often associated with chest pain, shortness of breath, palpitations, and anxiety as well as characteristic EKG findings and elevation of serum markers including creatine kinase-MB fraction and troponin. Evidence: TAS. Frequency: Occasional (HP:0040283, a Human Phenotype Ontology term). (ORPHA:90064)
- Acidosis (HP:0001941, a Human Phenotype Ontology term): Abnormal acid accumulation or depletion of base. Evidence: TAS. Frequency: Occasional (HP:0040283, a Human Phenotype Ontology term). (ORPHA:90064)
- Paralysis (HP:0003470, a Human Phenotype Ontology term): Paralysis of voluntary muscles means loss of contraction due to interruption of one or more motor pathways from the brain to the muscle fibers. Although the word paralysis is often used interchangeably to mean either complete or partial loss of muscle strength, it is preferable to use paralysis or plegia for complete or severe loss of muscle strength, and paresis for partial or slight loss. Motor paralysis results from deficits of the upper motor neurons (corticospinal, corticobulbar, or subcorticospinal). Motor paralysis is often accompanied by an impairment in the facility of movement. Evidence: TAS. Frequency: Occasional (HP:0040283, a Human Phenotype Ontology term). (ORPHA:90064)
- Supraventricular tachycardia (HP:0004755, a Human Phenotype Ontology term): Supraventricular tachycardia (SVT) is an abnormally increased heart rate (over 100 beats per minute at rest) with origin above the level of the ventricles. Evidence: TAS. Frequency: Occasional (HP:0040283, a Human Phenotype Ontology term). (ORPHA:90064)
- Gangrene (HP:0100758, a Human Phenotype Ontology term): A serious and potentially life-threatening condition that arises when a considerable mass of body tissue dies (necrosis). Evidence: TAS. Frequency: Occasional (HP:0040283, a Human Phenotype Ontology term). (ORPHA:90064)
These phenotypes are associated with the disease Acute peripheral arterial occlusion (ORPHA:90064, an Orphanet rare-disease identifier).